Phenotypes associated with the disease autosomal dominant nonsyndromic hearing loss 33 (OMIM:614211):
- Progressive (HP:0003676): Applies to a disease manifestation that increases in scope or severity over the course of time, i.e., that worsens with age. Evidence: PCS. (PMID:19183916)
- Juvenile onset (HP:0003621): Onset of signs or symptoms of disease between the age of 5 and 15 years. Evidence: PCS. (PMID:19183916)
- Sensorineural hearing impairment (HP:0000407): A type of hearing impairment in one or both ears related to an abnormal functionality of the cochlear nerve. Evidence: PCS. (PMID:19183916)
- Young adult onset (HP:0011462): Onset of disease at the age of between 16 and 40 years. Evidence: PCS. (PMID:19183916)
- Tinnitus (HP:0000360): Tinnitus is an auditory perception that can be described as the experience of sound, in the ear or in the head, in the absence of external acoustic stimulation. Evidence: PCS. (PMID:19183916)
- Autosomal dominant inheritance (HP:0000006): A mode of inheritance that is observed for traits related to a gene encoded on one of the autosomes (i.e., the human chromosomes 1-22) in which a trait manifests in heterozygotes. In the context of medical genetics, an autosomal dominant disorder is caused when a single copy of the mutant allele is present. Males and females are affected equally, and can both transmit the disorder with a risk of 50% for each child of inheriting the mutant allele. Evidence: PCS. (PMID:19183916)